Phenotypes associated with the disease spermatogenic failure 95 (OMIM:620917, an entry in Online Mendelian Inheritance in Man):
- Irregularly shaped sperm tail (HP:0033393, a Human Phenotype Ontology term): Irregular or changing caliber (diameter) along the tail of the sperm. Evidence: PCS. Frequency: 2/2. (PMID:36752199)
- Low semen volume (HP:6000135, a Human Phenotype Ontology term): Volume of semen in ejaculate below the lower limit of normal. This finding can be ascertained by semen analysis. Comment: Sperm are produced within the testis, in the process of spermatogenesis, then travel through the male reproductive tract (the seminiferous tubules, epididymis, vas deferens, prostate and urethra). As the sperm travel, seminal fluid is added from the seminal vesicles, prostate, testis and epididymis and periurethral glands. The function of the ejaculate is to transport sperm into the female genital tract and to provide a suitable environment for sperm survival during this transit. Evidence: PCS. Frequency: 0/5. (PMID:36752199)
- Coiled sperm flagella (HP:0032560, a Human Phenotype Ontology term): Sperm cells whose flagella are twisted (coiled). Evidence: PCS. Frequency: 1/2. (PMID:36752199)
- Reduced progressive sperm motility (HP:0034011, a Human Phenotype Ontology term): A reduced proportion of sperm that move in a straight line or large circles; alternatively, an increased proportion of sperm that move in tight circles or in some other non-linear fashion. Evidence: PCS. Frequency: 4/4. (PMID:36752199)
- Young adult onset (HP:0011462, a Human Phenotype Ontology term): Onset of disease at the age of between 16 and 40 years. Evidence: PCS. Frequency: 6/6. (PMID:36752199)
- Reduced sperm motility (HP:0012207, a Human Phenotype Ontology term): An abnormal reduction in the mobility of ejaculated sperm. Evidence: PCS. Frequency: 4/4. (PMID:36752199)
- Autosomal recessive inheritance (HP:0000007, a Human Phenotype Ontology term): A mode of inheritance that is observed for traits related to a gene encoded on one of the autosomes (i.e., the human chromosomes 1-22) in which a trait manifests in individuals with two pathogenic alleles, either homozygotes (two copies of the same mutant allele) or compound heterozygotes (whereby each copy of a gene has a distinct mutant allele). Evidence: PCS. (PMID:36752199)
- Bent sperm flagella (HP:0034811, a Human Phenotype Ontology term): The proportion of sperm cells whose flagella is sharply curved or has a sharp angle is above normal limits. Evidence: PCS. Frequency: 0/2. (PMID:36752199)
- Absent sperm flagella (HP:0032558, a Human Phenotype Ontology term): Sperm cells lacking flagella. Evidence: PCS. Frequency: 1/2. (PMID:36752199)
- Azoospermia (HP:0000027, a Human Phenotype Ontology term): Absence of any measurable level of sperm,whereby spermatozoa cannot be observed even after centrifugation of the semen pellet. Evidence: PCS. Frequency: 1/5. (PMID:36752199)
- Short sperm flagella (HP:0032559, a Human Phenotype Ontology term): Sperm cells with abnormally short flagella. Evidence: PCS. Frequency: 1/2. (PMID:36752199)